Phenotypes associated with the disease periodontitis, aggressive 1 (OMIM:170650):
- Severe periodontitis (HP:0000166): Increased susceptibility to periodontitis, as manifested by severe periodontal infection with rapid alveolar bone loss, tooth mobility, and premature tooth exfoliation. Evidence: PCS. Frequency: 4/4. Onset: Infantile onset (HP:0003593). (PMID:10662808)
- Premature loss of teeth (HP:0006480): Exfoliation of a tooth more than 2 SD earlier than the normal age for the deciduous teeth and not related to traume or neglect. Exfoliation of a permanent tooth is per se abnormal. Evidence: PCS. (PMID:10662808)
- Autosomal recessive inheritance (HP:0000007): A mode of inheritance that is observed for traits related to a gene encoded on one of the autosomes (i.e., the human chromosomes 1-22) in which a trait manifests in individuals with two pathogenic alleles, either homozygotes (two copies of the same mutant allele) or compound heterozygotes (whereby each copy of a gene has a distinct mutant allele). Evidence: PCS. (PMID:10662808)
- Gingival recession (HP:0030816): The loss of gum tissue. The result is that gum tissue is recessed and its position on the tooth is lowered, exposing the roots of the teeth. Evidence: PCS. (PMID:10662808)
- Palmoplantar hyperkeratosis (HP:0000972): Abnormal thickening of the skin localized to the palm of the hand and the sole of the foot. Evidence: PCS. Frequency: 0/4. (PMID:10662808)